Phenotypes associated with the disease autosomal recessive nonsyndromic hearing loss 79 (OMIM:613307):
- Delayed speech and language development (HP:0000750): A degree of language development that is significantly below the norm for a child of a specified age. Evidence: IEA. Onset: Childhood onset (HP:0011463). (OMIM:613307)
- Progressive sensorineural hearing impairment (HP:0000408): A progressive form of sensorineural hearing impairment. Evidence: TAS. (OMIM:613307)
- Sensorineural hearing impairment (HP:0000407): A type of hearing impairment in one or both ears related to an abnormal functionality of the cochlear nerve. Evidence: IEA. Onset: Childhood onset (HP:0011463). (OMIM:613307)
- Autosomal recessive inheritance (HP:0000007): A mode of inheritance that is observed for traits related to a gene encoded on one of the autosomes (i.e., the human chromosomes 1-22) in which a trait manifests in individuals with two pathogenic alleles, either homozygotes (two copies of the same mutant allele) or compound heterozygotes (whereby each copy of a gene has a distinct mutant allele). Evidence: TAS. (OMIM:613307)